Phenotypes associated with the disease neuronal ceroid lipofuscinosis 11 (OMIM:614706, an entry in Online Mendelian Inheritance in Man):
- Decreased circulating progranulin concentration (HP:6001187, a Human Phenotype Ontology term): The concentration of progranulin in the blood circulation is below the lower limit of normal. Evidence: PCS. (PMID:29053785)
- Generalized myoclonic seizure (HP:0002123, a Human Phenotype Ontology term): A generalized myoclonic seizure is a type of generalized motor seizure characterized by bilateral, sudden, brief (<100 ms) involuntary single or multiple contraction of muscles or muscle groups of variable topography (axial, proximal limb, distal). Myoclonus is less regularly repetitive and less sustained than is clonus. Evidence: PCS. Frequency: 1/2. (PMID:22608501)
- Cerebellar atrophy (HP:0001272, a Human Phenotype Ontology term): Cerebellar atrophy is defined as a cerebellum with initially normal structures, in a posterior fossa with normal size, which displays enlarged fissures (interfolial spaces) in comparison to the foliae secondary to loss of tissue. Cerebellar atrophy implies irreversible loss of tissue and result from an ongoing progressive disease until a final stage is reached or a single injury, e.g. an intoxication or infectious event. Evidence: PCS. Frequency: 1/2. (PMID:22608501)
- Seizure (HP:0001250, a Human Phenotype Ontology term): A seizure is an intermittent abnormality of nervous system physiology characterized by a transient occurrence of signs and/or symptoms due to abnormal excessive or synchronous neuronal activity in the brain. Evidence: PCS. Frequency: 2/2. (PMID:22608501)
- Ataxia (HP:0001251, a Human Phenotype Ontology term): Ataxia refers to impaired coordination of voluntary muscle movement. Cerebellar ataxia refers to ataxia due to dysfunction of the cerebellum. This causes a variety of elementary neurological deficits including asynergy (lack of coordination between muscles, limbs and joints), dysmetria (lack of ability to judge distances that can lead to under- or overshoot in grasping movements), and dysdiadochokinesia (inability to perform rapid movements requiring antagonizing muscle groups to be switched on and off repeatedly). Evidence: PCS. Frequency: 2/2. (PMID:22608501)
- Intermediate young adult onset (HP:0025709, a Human Phenotype Ontology term): Onset of disease at an age of greater than or equal to 19 to under 25 years. Evidence: PCS. Frequency: 2/2. (PMID:22608501)
- EEG with generalized polyspikes (HP:0012001, a Human Phenotype Ontology term): EEG with repetitive generalized sharp transient waves of a duration less than 80 msec. Evidence: PCS. Frequency: 2/2. (PMID:22608501)
- Autosomal recessive inheritance (HP:0000007, a Human Phenotype Ontology term): A mode of inheritance that is observed for traits related to a gene encoded on one of the autosomes (i.e., the human chromosomes 1-22) in which a trait manifests in individuals with two pathogenic alleles, either homozygotes (two copies of the same mutant allele) or compound heterozygotes (whereby each copy of a gene has a distinct mutant allele). Evidence: PCS. (PMID:22608501)
- Optic atrophy (HP:0000648, a Human Phenotype Ontology term): Atrophy of the optic nerve. Optic atrophy results from the death of the retinal ganglion cell axons that comprise the optic nerve and manifesting as a pale optic nerve on fundoscopy. Evidence: PCS. Frequency: 1/1. (PMID:22608501)
- Visual impairment (HP:0000505, a Human Phenotype Ontology term): Visual impairment (or vision impairment) is vision loss (of a person) to such a degree as to qualify as an additional support need through a significant limitation of visual capability resulting from either disease, trauma, or congenital or degenerative conditions that cannot be corrected by conventional means, such as refractive correction, medication, or surgery. Evidence: PCS. Frequency: 2/2. (PMID:22608501)
- Mental deterioration (HP:0001268, a Human Phenotype Ontology term): Loss of previously present mental abilities, generally in adults. Evidence: PCS. Frequency: 1/2. (PMID:22608501)
- Retinal dystrophy (HP:0000556, a Human Phenotype Ontology term): Retinal dystrophy is an abnormality of the retina associated with a hereditary process. Retinal dystrophies are defined by their predominantly monogenic inheritance and they are frequently associated with loss or dysfunction of photoreceptor cells as a primary or secondary event. Evidence: PCS. Frequency: 1/2. (PMID:22608501)
- Rapidly progressive (HP:0003678, a Human Phenotype Ontology term): Applies to a disease manifestation that quickly increases in scope or severity over the course of time. Evidence: PCS. (PMID:22608501)